- D-2-hydroxyglutaric acidemia (HP:0040146). Evidence: PCS. Frequency: 7/7. (PMID:20847235)
- D-2-hydroxyglutaric aciduria (HP:0012321): An increased concentration of 2-hydroxyglutaric acid in the urine. Evidence: PCS. Frequency: 14/14. (PMID:20847235)
- Seizure (HP:0001250): A seizure is an intermittent abnormality of nervous system physiology characterized by a transient occurrence of signs and/or symptoms due to abnormal excessive or synchronous neuronal activity in the brain. Evidence: TAS. (OMIM:613657)
- Global developmental delay (HP:0001263): A delay in the achievement of motor or mental milestones in the domains of development of a child, including motor skills, speech and language, cognitive skills, and social and emotional skills. This term should only be used to describe children younger than five years of age. Evidence: TAS. (OMIM:613657)
- Hypotonia (HP:0001252): Hypotonia is an abnormally low muscle tone (the amount of tension or resistance to movement in a muscle). Even when relaxed, muscles have a continuous and passive partial contraction which provides some resistance to passive stretching. Hypotonia thus manifests as diminished resistance to passive stretching. Hypotonia is not the same as muscle weakness, although the two conditions can co-exist. Evidence: TAS. (OMIM:613657)
- Cardiomyopathy (HP:0001638): A myocardial disorder in which the heart muscle is structurally and functionally abnormal, in the absence of coronary artery disease, hypertension, valvular disease and congenital heart disease sufficient to cause the observed myocardial abnormality. Evidence: TAS. (OMIM:613657)
- Autosomal dominant inheritance (HP:0000006): A mode of inheritance that is observed for traits related to a gene encoded on one of the autosomes (i.e., the human chromosomes 1-22) in which a trait manifests in heterozygotes. In the context of medical genetics, an autosomal dominant disorder is caused when a single copy of the mutant allele is present. Males and females are affected equally, and can both transmit the disorder with a risk of 50% for each child of inheriting the mutant allele. Evidence: PCS. (PMID:20847235)
These phenotypes are associated with the disease d-2-hydroxyglutaric aciduria 2 (OMIM:613657).